Phenotypes associated with the disease autism (OMIM:209850):
- Delayed speech and language development (HP:0000750): A degree of language development that is significantly below the norm for a child of a specified age. Evidence: IEA. (OMIM:209850)
- EEG abnormality (HP:0002353): Abnormality observed by electroencephalogram (EEG), which is used to record of the brain's spontaneous electrical activity from multiple electrodes placed on the scalp. Evidence: IEA. Frequency: Frequent (HP:0040282). (OMIM:209850)
- Seizure (HP:0001250): A seizure is an intermittent abnormality of nervous system physiology characterized by a transient occurrence of signs and/or symptoms due to abnormal excessive or synchronous neuronal activity in the brain. Evidence: IEA. Frequency: Frequent (HP:0040282). (OMIM:209850)
- Increased serum serotonin (HP:0003144): A increased concentration of serotonin in the blood. Evidence: IEA. Frequency: Frequent (HP:0040282). (OMIM:209850)
- Childhood onset (HP:0011463): Onset of disease at the age of between 1 and 5 years. Evidence: IEA. (OMIM:209850)
- Autism (HP:0000717): Autism is a neurodevelopmental disorder characterized by impaired social interaction and communication, and by restricted and repetitive behavior. Autism begins in childhood. It is marked by the presence of markedly abnormal or impaired development in social interaction and communication and a markedly restricted repertoire of activity and interest. Manifestations of the disorder vary greatly depending on the developmental level and chronological age of the individual (DSM-IV). Evidence: IEA. (OMIM:209850)
- Reduced ability to form peer relationships (HP:0000728): Difficulty to establish relations with others in a comparable social group (peers) that may be manifested in pehnomena such as not being able to initiative a conversation, understand social cues, or to discuss shared interests. This feature is associated with poor integration within a community or group. Evidence: IEA. (OMIM:209850)
- Restrictive behavior (HP:0000723): Behavior characterized by an abnormal limitation to a few interests and activities. Evidence: TAS. (OMIM:209850)
- Motor stereotypy (HP:0000733): Use of the same abnormal action in response to certain triggers or at random. They may be used as a way to regulate one's internal state but must otherwise have no apparent functional purpose. Evidence: TAS. (OMIM:209850)
- Non-Mendelian inheritance (HP:0001426): A mode of inheritance that depends on genetic determinants in more than one gene. Evidence: IEA. (OMIM:209850)
- Abnormal nonverbal communicative behavior (HP:0000758): Abnormalities in eye contact, communicative facial expressions, gesture use, or the use of others' bodies to communicate convey shared meanings within a culture that replace or supplement verbal communication. Evidence: TAS. (OMIM:209850)
- Sporadic (HP:0003745): Cases of the disease in question occur without a previous family history, i.e., as isolated cases without being transmitted from a parent and without other siblings being affected. Evidence: IEA. (OMIM:209850)
- Lack of spontaneous play (HP:0000721). Evidence: IEA. (OMIM:209850)
- Inflexible adherence to routines (HP:0000732): A need to strictly adhere to repetitive routines or patterns of behavior which are created by the environment. One becomes upset or distressed when their routines are disrupted or altered. Evidence: IEA. (OMIM:209850)
- Intellectual disability (HP:0001249): The term intellectual disability or intellectual developmental disorder is used to describe significantly sub-average intellectual and adaptive functioning based on clinical assessment and as measured by individually administered, appropriately normed, standardized and validated tests of intellectual functioning and adaptive behavior, with onset during the developmental period from infancy through adolescence. Evidence: IEA. (OMIM:209850)